- Short stature (HP:0004322): A height below that which is expected according to age and gender norms. Although there is no universally accepted definition of short stature, many refer to "short stature" as height more than 2 standard deviations below the mean for age and gender (or below the 3rd percentile for age and gender dependent norms). Evidence: PCS. (OMIM:236450)
- Nephrotic syndrome (HP:0000100): Nephrotic syndrome is a collection of findings resulting from glomerular dysfunction with an increase in glomerular capillary wall permeability associated with pronounced proteinuria. Nephrotic syndrome refers to the constellation of clinical findings that result from severe renal loss of protein, with Proteinuria and hypoalbuminemia, edema, and hyperlipidemia. Evidence: PCS. (OMIM:236450)
- Autosomal recessive inheritance (HP:0000007): A mode of inheritance that is observed for traits related to a gene encoded on one of the autosomes (i.e., the human chromosomes 1-22) in which a trait manifests in individuals with two pathogenic alleles, either homozygotes (two copies of the same mutant allele) or compound heterozygotes (whereby each copy of a gene has a distinct mutant allele). Evidence: PCS. Frequency: 20/20. (OMIM:236450)
- Feeding difficulties in infancy (HP:0008872): Impaired feeding performance of an infant as manifested by difficulties such as weak and ineffective sucking, brief bursts of sucking, and falling asleep during sucking. There may be difficulties with chewing or maintaining attention. Evidence: PCS. (OMIM:236450)
- Severe intellectual disability (HP:0010864): Severe intellectual disability (ID) is defined as a type of ID characterized by severely sub-average adaptive functioning and intellectual functioning, with an intelligence quotient (IQ) the range of 20-34. Evidence: TAS. (OMIM:236450)
These phenotypes are associated with the disease Hutterite cerebroosteonephrodysplasia syndrome (OMIM:236450).